- Progressive (HP:0003676): Applies to a disease manifestation that increases in scope or severity over the course of time, i.e., that worsens with age. Evidence: TAS. (OMIM:600101)
- Hearing impairment (HP:0000365): A decreased magnitude of the sensory perception of sound. Evidence: TAS. (OMIM:600101)
- Tinnitus (HP:0000360): Tinnitus is an auditory perception that can be described as the experience of sound, in the ear or in the head, in the absence of external acoustic stimulation. Evidence: TAS. (OMIM:600101)
- Autosomal dominant inheritance (HP:0000006): A mode of inheritance that is observed for traits related to a gene encoded on one of the autosomes (i.e., the human chromosomes 1-22) in which a trait manifests in heterozygotes. In the context of medical genetics, an autosomal dominant disorder is caused when a single copy of the mutant allele is present. Males and females are affected equally, and can both transmit the disorder with a risk of 50% for each child of inheriting the mutant allele. Evidence: IEA. (OMIM:600101)
These phenotypes are associated with the disease autosomal dominant nonsyndromic hearing loss 2A (OMIM:600101).